Phenotypes associated with the disease melanoma, malignant familial intraocular (OMIM:155700):
- Uveal melanoma (HP:0007716): A malignant melanoma originating within the eye. The tumor originates from the melanocytes in the uvea (which comprises the iris, ciliary body, and choroid). Evidence: TAS. (OMIM:155700)
- Autosomal dominant inheritance (HP:0000006): A mode of inheritance that is observed for traits related to a gene encoded on one of the autosomes (i.e., the human chromosomes 1-22) in which a trait manifests in heterozygotes. In the context of medical genetics, an autosomal dominant disorder is caused when a single copy of the mutant allele is present. Males and females are affected equally, and can both transmit the disorder with a risk of 50% for each child of inheriting the mutant allele. Evidence: TAS. (OMIM:155700)